- Microcephaly (HP:0000252): Head circumference below 2 standard deviations below the mean for age and gender. Evidence: PCS. Frequency: 2/3. (PMID:23603762)
- Spastic tetraplegia (HP:0002510): Spastic paralysis affecting all four limbs. Evidence: PCS. Frequency: 2/3. (PMID:23603762)
- Subcortical band heterotopia (HP:0032409): A form of subcortical heterotopia with mislocalized gray matter within the white matter.It is defined as longitudinal bands of gray matter located deep to the cerebral cortex and separated from it by a thin layer of normal appearing white matter. It is part of the lissencephaly spectrum. Evidence: PCS. Frequency: 1/3. (PMID:23603762)
- Thick corpus callosum (HP:0007074): Increased vertical dimension of the corpus callosum. This feature can be visualized by sagittal sections on magnetic resonance tomography imaging of the brain. Evidence: PCS. Frequency: 2/3. (PMID:23603762)
- Cataract (HP:0000518): A cataract is an opacity or clouding that develops in the crystalline lens of the eye or in its capsule. Evidence: PCS. Frequency: 1/3. (PMID:23603762)
- Seizure (HP:0001250): A seizure is an intermittent abnormality of nervous system physiology characterized by a transient occurrence of signs and/or symptoms due to abnormal excessive or synchronous neuronal activity in the brain. Evidence: PCS. Frequency: 2/3. (PMID:23603762)
- Global developmental delay (HP:0001263): A delay in the achievement of motor or mental milestones in the domains of development of a child, including motor skills, speech and language, cognitive skills, and social and emotional skills. This term should only be used to describe children younger than five years of age. Evidence: PCS. Frequency: 3/3. (PMID:23603762)
- Agyria (HP:0031882): A congenital abnormality of the cerebral hemisphere characterized by lack of gyrations (convolutions) of the cerebral cortex. Agyria is defined as cortical regions lacking gyration with sulci great than 3 cm apart and cerebral cortex thicker than 5 mm. Evidence: PCS. Frequency: 2/3. (PMID:23603762)
- Pachygyria (HP:0001302): Pachygyria is a malformation of cortical development with abnormally wide gyri with sulci 1,5-3 cm apart and abnormally thick cortex measuring more than 5 mm (radiological definition). See also neuropathological definitions for 2-, 3-, and 4-layered lissencephaly. Evidence: PCS. Frequency: 3/3. (PMID:23603762)
- Autosomal dominant inheritance (HP:0000006): A mode of inheritance that is observed for traits related to a gene encoded on one of the autosomes (i.e., the human chromosomes 1-22) in which a trait manifests in heterozygotes. In the context of medical genetics, an autosomal dominant disorder is caused when a single copy of the mutant allele is present. Males and females are affected equally, and can both transmit the disorder with a risk of 50% for each child of inheriting the mutant allele. Evidence: PCS. (PMID:23603762)
- Thin corpus callosum (HP:0033725): An abnormally thin corpus callous, due to atrophy, hypoplasia or agenesis. This term is intended to be used in situations where it is not known if thinning of the corpus callosum (for instance, as visualized by magnetic resonance tomography) is due to abnormal development (e.g. a leukodystrophy) or atrophy following normal development (e.g. neurodegeneration). Evidence: PCS. Frequency: 1/3. (PMID:23603762)
- Infantile spasms (HP:0012469): Infantile spasms represent a subset of "epileptic spasms". Infantile Spasms are epileptic spasms starting in the first year of life (infancy). Evidence: PCS. Frequency: 1/3. (PMID:23603762)
These phenotypes are associated with the disease complex cortical dysplasia with other brain malformations 4 (OMIM:615412).